Phenotypes associated with the disease Birk-Barel syndrome (OMIM:612292):
- Highly arched eyebrow (HP:0002553): Increased height of the central portion of the eyebrow, forming a crescent, semicircular, or inverted U shape. Evidence: PCS. (PMID:27151206)
- Narrow forehead (HP:0000341): Width of the forehead or distance between the frontotemporales is more than two standard deviations below the mean (objective); or apparently narrow intertemporal region (subjective). Evidence: PCS. Frequency: 4/4. (PMID:27151206)
- Dysphagia (HP:0002015): Difficulty in swallowing. Evidence: PCS. (PMID:27151206)
- Submucous cleft soft palate (HP:0011819): A cleft of the muscular (soft) portion of the palate that is covered by mucous membrane. Soft-palate submucous clefts are characterized by a midline deficiency or lack of muscle tissue. Evidence: PCS. Frequency: 8/19. (PMID:27151206)
- Tented upper lip vermilion (HP:0010804): Triangular appearance of the oral aperture with the apex in the midpoint of the upper vermilion and the lower vermilion forming the base. Evidence: PCS. Frequency: 11/19. (PMID:27151206)
- Long face (HP:0000276): Facial height (length) is more than 2 standard deviations above the mean (objective); or, an apparent increase in the height (length) of the face (subjective). Evidence: PCS. Frequency: 8/19. (PMID:27151206)
- Bifid uvula (HP:0000193): Uvula separated into two parts most easily seen at the tip. Evidence: PCS. Frequency: 1/19. (PMID:27151206)
- Global developmental delay (HP:0001263): A delay in the achievement of motor or mental milestones in the domains of development of a child, including motor skills, speech and language, cognitive skills, and social and emotional skills. This term should only be used to describe children younger than five years of age. Evidence: PCS. Frequency: 4/4. (PMID:27151206)
- Hypotonia (HP:0001252): Hypotonia is an abnormally low muscle tone (the amount of tension or resistance to movement in a muscle). Even when relaxed, muscles have a continuous and passive partial contraction which provides some resistance to passive stretching. Hypotonia thus manifests as diminished resistance to passive stretching. Hypotonia is not the same as muscle weakness, although the two conditions can co-exist. Evidence: PCS. (PMID:27151206)
- Microretrognathia (HP:0000308): A form of developmental hypoplasia of the mandible in which the mandible is mislocalised posteriorly. Evidence: PCS. Frequency: 13/19. (PMID:27151206)
- Single transverse palmar crease (HP:0000954): The distal and proximal transverse palmar creases are merged into a single transverse palmar crease. Evidence: PCS. Frequency: 3/19. (PMID:27151206)
- Feeding difficulties in infancy (HP:0008872): Impaired feeding performance of an infant as manifested by difficulties such as weak and ineffective sucking, brief bursts of sucking, and falling asleep during sucking. There may be difficulties with chewing or maintaining attention. Evidence: PCS. Frequency: 4/4. Onset: Infantile onset (HP:0003593). (PMID:27151206)
- Long eyelashes (HP:0000527): Mid upper eyelash length >10 mm or increased length of the eyelashes (subjective). Evidence: PCS. Frequency: 10/19. (PMID:27151206)
- Reduced subcutaneous adipose tissue (HP:0003758): A reduced amount of fat tissue in the lowest layer of the integument. This feature can be appreciated by a reduced skinfold thickness. Evidence: PCS. Frequency: 8/19. (PMID:27151206)
- High palate (HP:0000218): Height of the palate more than 2 SD above the mean (objective) or palatal height at the level of the first permanent molar more than twice the height of the teeth (subjective). Evidence: PCS. Frequency: 8/19. (PMID:27151206)
- Sacral dimple (HP:0000960): A cutaneous indentation resulting from tethering of the skin to underlying structures (bone) of the intergluteal cleft. Evidence: PCS. Frequency: 1/4. (PMID:27151206)
- Short philtrum (HP:0000322): Distance between nasal base and midline upper lip vermilion border more than 2 SD below the mean. Alternatively, an apparently decreased distance between nasal base and midline upper lip vermilion border. Evidence: PCS. Frequency: 13/19. (PMID:27151206)
- Autosomal dominant inheritance (HP:0000006): A mode of inheritance that is observed for traits related to a gene encoded on one of the autosomes (i.e., the human chromosomes 1-22) in which a trait manifests in heterozygotes. In the context of medical genetics, an autosomal dominant disorder is caused when a single copy of the mutant allele is present. Males and females are affected equally, and can both transmit the disorder with a risk of 50% for each child of inheriting the mutant allele. Evidence: PCS. (PMID:27151206)
- Intellectual disability (HP:0001249): The term intellectual disability or intellectual developmental disorder is used to describe significantly sub-average intellectual and adaptive functioning based on clinical assessment and as measured by individually administered, appropriately normed, standardized and validated tests of intellectual functioning and adaptive behavior, with onset during the developmental period from infancy through adolescence. Evidence: PCS. (PMID:27151206)